Phenotypes associated with the disease split-hand and split-foot with hypodontia (OMIM:183500):
- Split foot (HP:0001839): A condition in which middle parts of the foot (toes and metatarsals) are missing giving a cleft appearance. The severity is very variable ranging from slightly hypoplastic 3rd toe over absent 2nd or 3rd toes as far as oligo- or monodactyl feet. Evidence: IEA. (OMIM:183500)
- Hypodontia (HP:0000668): The absence of five or less teeth from the normal series by a failure to develop. Evidence: IEA. (OMIM:183500)
- Split hand (HP:0001171): A condition in which middle parts of the hand (fingers and metacarpals) are missing giving a cleft appearance. The severity is very variable ranging from slightly hypoplastic middle fingers over absent middle fingers as far as oligo- or monodactyl hands. Evidence: IEA. (OMIM:183500)
- Autosomal dominant inheritance (HP:0000006): A mode of inheritance that is observed for traits related to a gene encoded on one of the autosomes (i.e., the human chromosomes 1-22) in which a trait manifests in heterozygotes. In the context of medical genetics, an autosomal dominant disorder is caused when a single copy of the mutant allele is present. Males and females are affected equally, and can both transmit the disorder with a risk of 50% for each child of inheriting the mutant allele. Evidence: IEA. (OMIM:183500)